Phenotypes associated with the disease Familial pseudohyperkalemia (ORPHA:90044):
- Hyperkalemia (HP:0002153): The concentration of potassium(1+) in the blood circulation is above the upper limit of normal. Evidence: TAS. Frequency: Very frequent (HP:0040281). (ORPHA:90044)
- Hypertension (HP:0000822): The presence of chronic increased pressure in the systemic arterial system. Evidence: TAS. Frequency: Frequent (HP:0040282). (ORPHA:90044)
- Stomatocytosis (HP:0004446): The presence of erythrocytes with a mouth-shaped (stoma) area of central pallor on peripheral blood smear. Evidence: TAS. Frequency: Frequent (HP:0040282). (ORPHA:90044)
- Reticulocytosis (HP:0001923): An elevation in the number of reticulocytes (immature erythrocytes) in the peripheral blood circulation. Evidence: TAS. Frequency: Occasional (HP:0040283). (ORPHA:90044)
- Increased mean corpuscular volume (HP:0005518): Larger than normal size of erythrocytes. Evidence: TAS. Frequency: Occasional (HP:0040283). (ORPHA:90044)
- Episodic hemolytic anemia (HP:0004802): A form of hemolytic anemia that occurs in repeated episodes. Evidence: TAS. Frequency: Very rare (HP:0040284). (ORPHA:90044)